Phenotypes associated with the disease isolated anterior cervical hypertrichosis (OMIM:600457):
- Anterior cervical hypertrichosis (HP:0004535): Anterior cervical hypertrichosis (ACH) or 'hairy throat' refers to the presence of a tuft of terminal hair on the anterior neck, just above the laryngeal prominence. Evidence: IEA. (OMIM:600457)